- Median cleft upper lip (HP:0000161): A type of cleft lip presenting as a midline (median) gap in the upper lip. Evidence: TAS. Frequency: Very frequent (HP:0040281). (ORPHA:3378)
- Cleft palate (HP:0000175): Cleft palate is a developmental defect of the palate resulting from a failure of fusion of the palatine processes and manifesting as a separation of the roof of the mouth (soft and hard palate). Evidence: TAS. Frequency: Very frequent (HP:0040281). (ORPHA:3378)
- Abnormal cranial suture/fontanelle morphology (HP:0000235): Any abnormality of the fontanelles (the regions covered by a thick membrane that normally ossify in the first two years of life) or the cranial sutures (the fibrous joints in which the articulating bones or cartilages of the skull are connected by sutural ligaments). Evidence: TAS. Frequency: Very frequent (HP:0040281). (ORPHA:3378)
- Malar flattening (HP:0000272): Underdevelopment of the malar prominence of the jugal bone (zygomatic bone in mammals), appreciated in profile, frontal view, and/or by palpation. Evidence: TAS. Frequency: Very frequent (HP:0040281). (ORPHA:3378)
- Low-set ears (HP:0000369): Upper insertion of the ear to the scalp below an imaginary horizontal line drawn between the inner canthi of the eye and extending posteriorly to the ear. Evidence: TAS. Frequency: Very frequent (HP:0040281). (ORPHA:3378)
- Cystic hygroma (HP:0000476): A cystic lymphatic lesion of the neck. Evidence: TAS. Frequency: Very frequent (HP:0040281). (ORPHA:3378)
- Anophthalmia (HP:0000528): Absence of the globe or eyeball. Evidence: TAS. Frequency: Very frequent (HP:0040281). (ORPHA:3378)
- Microphthalmia (HP:0000568): A developmental anomaly characterized by abnormal smallness of one or both eyes. Evidence: TAS. Frequency: Very frequent (HP:0040281). (ORPHA:3378)
- Hypotelorism (HP:0000601): Interpupillary distance less than 2 SD below the mean (alternatively, the appearance of an decreased interpupillary distance or closely spaced eyes). Evidence: TAS. Frequency: Very frequent (HP:0040281). (ORPHA:3378)
- Postaxial hand polydactyly (HP:0001162): Supernumerary digits located at the ulnar side of the hand (that is, on the side with the fifth finger). Evidence: TAS. Frequency: Very frequent (HP:0040281). (ORPHA:3378)
- Seizure (HP:0001250): A seizure is an intermittent abnormality of nervous system physiology characterized by a transient occurrence of signs and/or symptoms due to abnormal excessive or synchronous neuronal activity in the brain. Evidence: TAS. Frequency: Very frequent (HP:0040281). (ORPHA:3378)
- Hypotonia (HP:0001252): Hypotonia is an abnormally low muscle tone (the amount of tension or resistance to movement in a muscle). Even when relaxed, muscles have a continuous and passive partial contraction which provides some resistance to passive stretching. Hypotonia thus manifests as diminished resistance to passive stretching. Hypotonia is not the same as muscle weakness, although the two conditions can co-exist. Evidence: TAS. Frequency: Very frequent (HP:0040281). (ORPHA:3378)
- Intrauterine growth retardation (HP:0001511): An abnormal restriction of fetal growth with fetal weight below the tenth percentile for gestational age. Evidence: TAS. Frequency: Very frequent (HP:0040281). (ORPHA:3378)
- Ventricular septal defect (HP:0001629): A hole between the two bottom chambers (ventricles) of the heart. The defect is centered around the most superior aspect of the ventricular septum. Evidence: TAS. Frequency: Very frequent (HP:0040281). (ORPHA:3378)
- Atrial septal defect (HP:0001631): Atrial septal defect (ASD) is a congenital abnormality of the interatrial septum that enables blood flow between the left and right atria via the interatrial septum. Evidence: TAS. Frequency: Very frequent (HP:0040281). (ORPHA:3378)
- Patent ductus arteriosus (HP:0001643): In utero, the ductus arteriosus (DA) serves to divert ventricular output away from the lungs and toward the placenta by connecting the main pulmonary artery to the descending aorta. A patent ductus arteriosus (PDA) in the first 3 days of life is a physiologic shunt in healthy term and preterm newborn infants, and normally is substantially closed within about 24 hours after bith and completely closed after about three weeks. Failure of physiologcal closure is referred to a persistent or patent ductus arteriosus (PDA). Depending on the degree of left-to-right shunting, PDA can have clinical consequences. Evidence: TAS. Frequency: Very frequent (HP:0040281). (ORPHA:3378)
- Hydrops fetalis (HP:0001789): The abnormal accumulation of fluid in two or more fetal compartments, including ascites, pleural effusion, pericardial effusion, and skin edema. Evidence: TAS. Frequency: Very frequent (HP:0040281). (ORPHA:3378)
- Abnormal speech pattern (HP:0002167): An abnormality in the sound (volume) or cadence (rate) of speech. Evidence: TAS. Frequency: Very frequent (HP:0040281). (ORPHA:3378)
- Abnormal pelvic girdle bone morphology (HP:0002644): An abnormality of the bony pelvic girdle, which is a ring of bones connecting the vertebral column to the femurs. Evidence: TAS. Frequency: Very frequent (HP:0040281). (ORPHA:3378)
- Bilateral single transverse palmar creases (HP:0007598): The distal and proximal transverse palmar creases are merged into a single transverse palmar crease on both hands. Evidence: TAS. Frequency: Very frequent (HP:0040281). (ORPHA:3378)
- Severe intellectual disability (HP:0010864): Severe intellectual disability (ID) is defined as a type of ID characterized by severely sub-average adaptive functioning and intellectual functioning, with an intelligence quotient (IQ) the range of 20-34. Evidence: TAS. Frequency: Very frequent (HP:0040281). (ORPHA:3378)
- Severe global developmental delay (HP:0011344): A severe delay in the achievement of motor or mental milestones in the domains of development of a child. Evidence: TAS. Frequency: Very frequent (HP:0040281). (ORPHA:3378)
- Abnormal cardiovascular system morphology (HP:0030680): Any structural anomaly of the heart and blood vessels. Evidence: TAS. Frequency: Very frequent (HP:0040281). (ORPHA:3378)
- Cognitive impairment (HP:0100543): Abnormal cognition is characterized by deficits in thinking, reasoning, or remembering. Evidence: TAS. Frequency: Very frequent (HP:0040281). (ORPHA:3378)
- Abnormal morphology of female internal genitalia (HP:0000008): An abnormality of the female internal genitalia. Evidence: TAS. Frequency: Frequent (HP:0040282). (ORPHA:3378)
- Cryptorchidism (HP:0000028): Testis in inguinal canal. That is, absence of one or both testes from the scrotum owing to failure of the testis or testes to descend through the inguinal canal to the scrotum. Evidence: TAS. Frequency: Frequent (HP:0040282). (ORPHA:3378)
- Abnormality of the ureter (HP:0000069): An abnormality of the ureter. The ureter is the duct by which urine passes from the kidney to the bladder. Evidence: TAS. Frequency: Frequent (HP:0040282). (ORPHA:3378)
- Hydronephrosis (HP:0000126): Severe distention of the kidney with dilation of the renal pelvis and calices. Evidence: TAS. Frequency: Frequent (HP:0040282). (ORPHA:3378)
- Abnormality of the dentition (HP:0000164): Any abnormality of the teeth. Evidence: TAS. Frequency: Frequent (HP:0040282). (ORPHA:3378)
- Long philtrum (HP:0000343): Distance between nasal base and midline upper lip vermilion border more than 2 SD above the mean. Alternatively, an apparently increased distance between nasal base and midline upper lip vermilion border. Evidence: TAS. Frequency: Frequent (HP:0040282). (ORPHA:3378)
- Abnormality of the middle ear (HP:0000370): An abnormality of the middle ear. Evidence: TAS. Frequency: Frequent (HP:0040282). (ORPHA:3378)
- Preauricular skin tag (HP:0000384): A rudimentary tag of skin often containing ear tissue including a core of cartilage and located just anterior to the auricle (outer part of the ear). Evidence: TAS. Frequency: Frequent (HP:0040282). (ORPHA:3378)
- Sensorineural hearing impairment (HP:0000407): A type of hearing impairment in one or both ears related to an abnormal functionality of the cochlear nerve. Evidence: TAS. Frequency: Frequent (HP:0040282). (ORPHA:3378)
- Abnormality of the eye (HP:0000478): Any abnormality of the eye, including location, spacing, and intraocular abnormalities. Evidence: TAS. Frequency: Frequent (HP:0040282). (ORPHA:3378)
- Deeply set eye (HP:0000490): An eye that is more deeply recessed into the plane of the face than is typical. Evidence: TAS. Frequency: Frequent (HP:0040282). (ORPHA:3378)
- Abnormal eyelash morphology (HP:0000499): An abnormality of the eyelashes. Evidence: TAS. Frequency: Frequent (HP:0040282). (ORPHA:3378)
- Abnormality of vision (HP:0000504): Abnormality of eyesight (visual perception). Evidence: TAS. Frequency: Frequent (HP:0040282). (ORPHA:3378)
- Cataract (HP:0000518): A cataract is an opacity or clouding that develops in the crystalline lens of the eye or in its capsule. Evidence: TAS. Frequency: Frequent (HP:0040282). (ORPHA:3378)
- Iris coloboma (HP:0000612): A coloboma of the iris. Evidence: TAS. Frequency: Frequent (HP:0040282). (ORPHA:3378)
- Optic atrophy (HP:0000648): Atrophy of the optic nerve. Optic atrophy results from the death of the retinal ganglion cell axons that comprise the optic nerve and manifesting as a pale optic nerve on fundoscopy. Evidence: TAS. Frequency: Frequent (HP:0040282). (ORPHA:3378)
- Abnormal rib morphology (HP:0000772): An anomaly of the rib. Evidence: TAS. Frequency: Frequent (HP:0040282). (ORPHA:3378)
- Narrow chest (HP:0000774): Reduced width of the chest from side to side, associated with a reduced distance from the sternal notch to the tip of the shoulder. Evidence: TAS. Frequency: Frequent (HP:0040282). (ORPHA:3378)
- Calvarial skull defect (HP:0001362): A localized defect in the bone of the skull resulting from abnormal embryological development. The defect is covered by normal skin. In some cases, skull x-rays have shown underlying lytic bone lesions which have closed before the age of one year. Evidence: TAS. Frequency: Frequent (HP:0040282). (ORPHA:3378)
- Abnormal lung lobation (HP:0002101): A developmental defect in the formation of pulmonary lobes. Evidence: TAS. Frequency: Frequent (HP:0040282). (ORPHA:3378)
- Chiari malformation (HP:0002308): Chiari malformation consists of a downward displacement of the cerebellar tonsils and the medulla through the foramen magnum, sometimes causing hydrocephalus as a result of obstruction of CSF outflow. Evidence: TAS. Frequency: Frequent (HP:0040282). (ORPHA:3378)
- Scoliosis (HP:0002650): The presence of an abnormal lateral curvature of the spine. Evidence: TAS. Frequency: Frequent (HP:0040282). (ORPHA:3378)
- High, narrow palate (HP:0002705): The presence of a high and narrow palate. Evidence: TAS. Frequency: Frequent (HP:0040282). (ORPHA:3378)
- Kyphosis (HP:0002808): Exaggerated anterior convexity of the thoracic vertebral column. Evidence: TAS. Frequency: Frequent (HP:0040282). (ORPHA:3378)
- Preauricular pit (HP:0004467): Small indentation anterior to the insertion of the ear. Evidence: TAS. Frequency: Frequent (HP:0040282). (ORPHA:3378)
- Capillary hemangioma (HP:0005306): The presence of a capillary hemangioma, which are hemangiomas with small endothelial spaces. Evidence: TAS. Frequency: Frequent (HP:0040282). (ORPHA:3378)
- Multiple renal cysts (HP:0005562): The presence of many cysts in the kidney. Evidence: TAS. Frequency: Frequent (HP:0040282). (ORPHA:3378)
- Abnormal dermatoglyphics (HP:0007477): An abnormality of dermatoglyphs (fingerprints), which are present on fingers, palms, toes, and soles. Evidence: TAS. Frequency: Frequent (HP:0040282). (ORPHA:3378)
- Abnormal retinal vascular morphology (HP:0008046): A structural abnormality of retinal vasculature. Evidence: TAS. Frequency: Frequent (HP:0040282). (ORPHA:3378)
- Aplasia/Hypoplasia of the iris (HP:0008053): Absence or underdevelopment of the iris. Evidence: TAS. Frequency: Frequent (HP:0040282). (ORPHA:3378)
- Abnormal antihelix morphology (HP:0009738): An abnormality of the antihelix. Evidence: TAS. Frequency: Frequent (HP:0040282). (ORPHA:3378)
- Abnormal helix morphology (HP:0011039): An abnormality of the helix. The helix is the outer rim of the ear that extends from the insertion of the ear on the scalp (root) to the termination of the cartilage at the earlobe. Evidence: TAS. Frequency: Frequent (HP:0040282). (ORPHA:3378)
- Ectrodactyly (HP:0100257): A condition in which middle parts of the hands and/or feet (digits and meta-carpals and -tarsals) are missing giving a cleft appearance. The severity is very variable ranging from slightly hypoplastic 3rd toe/fingers over absent 2nd or 3rd toes/fingers as far as oligo- or monodactyl hands and/or feet. Evidence: TAS. Frequency: Frequent (HP:0040282). (ORPHA:3378)
- Displacement of the urethral meatus (HP:0100627): A displacement of the external urethral orifice from its normal position (in males normally placed at the tip of glans penis, in females normally placed about 2.5 cm behind the glans clitoridis and immediately in front of that of the vagina). Evidence: TAS. Frequency: Frequent (HP:0040282). (ORPHA:3378)
- Hernia (HP:0100790). Evidence: TAS. Frequency: Frequent (HP:0040282). (ORPHA:3378)
These phenotypes are associated with the disease Trisomy 13 syndrome (ORPHA:3378).